- Facial asymmetry (HP:0000324): An abnormal difference between the left and right sides of the face. Evidence: TAS. Frequency: Very frequent (HP:0040281). (ORPHA:2549)
- Abnormality of the inner ear (HP:0000359): An abnormality of the inner ear. Evidence: TAS. Frequency: Very frequent (HP:0040281). (ORPHA:2549)
- Short mandibular rami (HP:0003778). Evidence: TAS. Frequency: Very frequent (HP:0040281). (ORPHA:2549)
- Laryngeal stridor (HP:0006511): An abnormal high-pitched noisy sound, occurring during inhalation or exhalation caused by the incomplete obstruction in the throat. Evidence: TAS. Frequency: Very frequent (HP:0040281). (ORPHA:2549)
- Microtia (HP:0008551): Underdevelopment of the external ear. Evidence: TAS. Frequency: Very frequent (HP:0040281). (ORPHA:2549)
- Aplasia/Hypoplasia of the thumb (HP:0009601): Hypoplastic/small or absent thumb. Evidence: TAS. Frequency: Very frequent (HP:0040281). (ORPHA:2549)
- Abnormal cardiovascular system morphology (HP:0030680): Any structural anomaly of the heart and blood vessels. Evidence: TAS. Frequency: Very frequent (HP:0040281). (ORPHA:2549)
- Vesicoureteral reflux (HP:0000076): Abnormal (retrograde) movement of urine from the bladder into ureters or kidneys related to inadequacy of the valvular mechanism at the ureterovesicular junction or other causes. Evidence: TAS. Frequency: Frequent (HP:0040282). (ORPHA:2549)
- Orofacial cleft (HP:0000202): The presence of a cleft (gap, opening, or groove) in the oral cavity, including cleft of the upper lip and/or cleft of the palate. Cleft of the upper lip is visible as a groove or fissure in the lip, most frequently due to a congenital failure of the maxillary and median nasal processes to fuse. Cleft palate is characterized by a grooved depression or fissure in the roof of the mouth, most often resulting from a congenital failure of the palate to fuse properly. Clefts of the lip and palate can occur individually or together. It is preferable to code each defect separately. Evidence: TAS. Frequency: Frequent (HP:0040282). (ORPHA:2549)
- Preauricular skin tag (HP:0000384): A rudimentary tag of skin often containing ear tissue including a core of cartilage and located just anterior to the auricle (outer part of the ear). Evidence: TAS. Frequency: Frequent (HP:0040282). (ORPHA:2549)
- Sensorineural hearing impairment (HP:0000407): A type of hearing impairment in one or both ears related to an abnormal functionality of the cochlear nerve. Evidence: TAS. Frequency: Frequent (HP:0040282). (ORPHA:2549)
- Atresia of the external auditory canal (HP:0000413): Absence or failure to form of the external auditory canal. Evidence: TAS. Frequency: Frequent (HP:0040282). (ORPHA:2549)
- EMG: myopathic abnormalities (HP:0003458): The presence of abnormal electromyographic patterns indicative of myopathy, such as small-short polyphasic motor unit potentials. Evidence: TAS. Frequency: Frequent (HP:0040282). (ORPHA:2549)
- Short stature (HP:0004322): A height below that which is expected according to age and gender norms. Although there is no universally accepted definition of short stature, many refer to "short stature" as height more than 2 standard deviations below the mean for age and gender (or below the 3rd percentile for age and gender dependent norms). Evidence: TAS. Frequency: Frequent (HP:0040282). (ORPHA:2549)
- Abnormality of the middle ear ossicles (HP:0004452): An abnormality of the middle-ear ossicles (three small bones called malleus, incus, and stapes) that are contained within the middle ear and serve to transmit sounds from the air to the fluid-filled labyrinth (cochlea). Evidence: TAS. Frequency: Frequent (HP:0040282). (ORPHA:2549)
- Preauricular pit (HP:0004467): Small indentation anterior to the insertion of the ear. Evidence: TAS. Frequency: Frequent (HP:0040282). (ORPHA:2549)
- Atrioventricular canal defect (HP:0006695): A defect of the atrioventricular septum of the heart. Evidence: TAS. Frequency: Frequent (HP:0040282). (ORPHA:2549)
- Renal hypoplasia/aplasia (HP:0008678): Absence or underdevelopment of the kidney. Evidence: TAS. Frequency: Frequent (HP:0040282). (ORPHA:2549)
- Distal urethral duplication (HP:0008706). Evidence: TAS. Frequency: Frequent (HP:0040282). (ORPHA:2549)
- Cognitive impairment (HP:0100543): Abnormal cognition is characterized by deficits in thinking, reasoning, or remembering. Evidence: TAS. Frequency: Frequent (HP:0040282). (ORPHA:2549)
- Abnormality of the genital system (HP:0000078): An abnormality of the genital system. Evidence: TAS. Frequency: Occasional (HP:0040283). (ORPHA:2549)
- Wide mouth (HP:0000154): Distance between the oral commissures more than 2 SD above the mean. Alternatively, an apparently increased width of the oral aperture (subjective). Evidence: TAS. Frequency: Occasional (HP:0040283). (ORPHA:2549)
- Cleft palate (HP:0000175): Cleft palate is a developmental defect of the palate resulting from a failure of fusion of the palatine processes and manifesting as a separation of the roof of the mouth (soft and hard palate). Evidence: TAS. Frequency: Occasional (HP:0040283). (ORPHA:2549)
- Conductive hearing impairment (HP:0000405): An abnormality of vibrational conductance of sound to the inner ear leading to impairment of sensory perception of sound. Evidence: TAS. Frequency: Occasional (HP:0040283). (ORPHA:2549)
- Preaxial hand polydactyly (HP:0001177): Supernumerary digits located at the radial side of the hand. Polydactyly (supernumerary digits) involving the thumb occurs in many distinct forms of high variability and severity. Ranging from fleshy nubbins over varying degrees of partial duplication/splitting to completely duplicated or even triplicated thumbs or preaxial (on the radial side of the hand) supernumerary digits. Evidence: TAS. Frequency: Occasional (HP:0040283). (ORPHA:2549)
- Triphalangeal thumb (HP:0001199): A thumb with three phalanges in a single, proximo-distal axis. Thus, this term applies if the thumb has an accessory phalanx, leading to a digit like appearance of the thumb. Evidence: TAS. Frequency: Occasional (HP:0040283). (ORPHA:2549)
- Ectopic anus (HP:0004397): Abnormal displacement or malposition of the anus. Evidence: TAS. Frequency: Occasional (HP:0040283). (ORPHA:2549)
- Aplasia/Hypoplasia of the lungs (HP:0006703). Evidence: TAS. Frequency: Occasional (HP:0040283). (ORPHA:2549)
- Aplasia/Hypoplasia affecting the eye (HP:0008056). Evidence: TAS. Frequency: Occasional (HP:0040283). (ORPHA:2549)
- Maternal diabetes (HP:0009800): Maternal diabetes can either be a gestational, mostly type 2 diabetes, or a type 1 diabetes. Essential is the resulting maternal hyperglycemia as a non-specific teratogen, imposing the same risk of congenital malformations to pregnant women with both type 1 and type2 diabetes. Evidence: TAS. Frequency: Occasional (HP:0040283). (ORPHA:2549)
- Non-midline cleft of the upper lip (HP:0100335): Clefting (gap or groove) of the upper lip affecting the lateral portions of the upper lip rather than the midline/median region. Evidence: TAS. Frequency: Occasional (HP:0040283). (ORPHA:2549)
These phenotypes are associated with the disease Oculoauriculovertebral spectrum with radial defects (ORPHA:2549).